- Shortened sleep phase (HP:0033063): A tendency to sleep fewer hours than usual while feeling well-rested. Evidence: PCS. Frequency: 6/7. (PMID:31473062)
- Autosomal dominant inheritance (HP:0000006): A mode of inheritance that is observed for traits related to a gene encoded on one of the autosomes (i.e., the human chromosomes 1-22) in which a trait manifests in heterozygotes. In the context of medical genetics, an autosomal dominant disorder is caused when a single copy of the mutant allele is present. Males and females are affected equally, and can both transmit the disorder with a risk of 50% for each child of inheriting the mutant allele. Evidence: PCS. (PMID:31473062)
These phenotypes are associated with the disease Short sleep, familial natural, 2 (OMIM:618591).